- Bilateral tonic-clonic seizure (HP:0002069): A bilateral tonic-clonic seizure is a seizure defined by a tonic (bilateral increased tone, lasting seconds to minutes) and then a clonic (bilateral sustained rhythmic jerking) phase. Evidence: PCS. Frequency: 4/4. Onset: Childhood onset (HP:0011463). (PMID:31020005)
- Delayed speech and language development (HP:0000750): A degree of language development that is significantly below the norm for a child of a specified age. Evidence: PCS. Frequency: 2/4. (PMID:31020005)
- Absent speech (HP:0001344): Complete lack of development of speech and language abilities. Evidence: PCS. Frequency: 1/4. (PMID:31020005)
- Global developmental delay (HP:0001263): A delay in the achievement of motor or mental milestones in the domains of development of a child, including motor skills, speech and language, cognitive skills, and social and emotional skills. This term should only be used to describe children younger than five years of age. Evidence: PCS. (PMID:31020005)
- Infantile onset (HP:0003593): Onset of signs or symptoms of disease between 28 days to one year of life. Evidence: PCS. Frequency: 4/4. (PMID:31020005)
- Intention tremor (HP:0002080): A type of kinetic tremor that occurs during target directed movement is called intention tremor. That is, an oscillatory cerebellar ataxia that tends to be absent when the limbs are inactive and during the first part of voluntary movement but worsening as the movement continues and greater precision is required (e.g., in touching a target such as the patient's nose or a physician's finger). Evidence: PCS. Frequency: 4/4. Onset: Infantile onset (HP:0003593). (PMID:31020005)
- Attention deficit hyperactivity disorder (HP:0007018): Attention deficit hyperactivity disorder (ADHD) manifests at age 2-3 years or by first grade at the latest. The main symptoms are distractibility, impulsivity, hyperactivity, and often trouble organizing tasks and projects, difficulty going to sleep, and social problems from being aggressive, loud, or impatient. Evidence: PCS. Frequency: 1/4. (PMID:31020005)
- Autosomal dominant inheritance (HP:0000006): A mode of inheritance that is observed for traits related to a gene encoded on one of the autosomes (i.e., the human chromosomes 1-22) in which a trait manifests in heterozygotes. In the context of medical genetics, an autosomal dominant disorder is caused when a single copy of the mutant allele is present. Males and females are affected equally, and can both transmit the disorder with a risk of 50% for each child of inheriting the mutant allele. Evidence: PCS. (PMID:31020005)
- Intellectual disability (HP:0001249): The term intellectual disability or intellectual developmental disorder is used to describe significantly sub-average intellectual and adaptive functioning based on clinical assessment and as measured by individually administered, appropriately normed, standardized and validated tests of intellectual functioning and adaptive behavior, with onset during the developmental period from infancy through adolescence. Evidence: PCS. Frequency: 3/4. (PMID:31020005)
These phenotypes are associated with the disease intellectual developmental disorder, autosomal dominant 69 (OMIM:617863).